- Thyroiditis (HP:0100646): Inflammation of the thyroid gland. Evidence: IEA. (OMIM:608175)
This phenotype is associated with the disease autoimmune thyroid disease, susceptibility to, 3 (OMIM:608175).